Phenotypes associated with the disease double nail for fifth toe (OMIM:126500):
- Abnormality of the skeletal system (HP:0000924): An abnormality of the skeletal system. Evidence: IEA. (OMIM:126500)
- Autosomal dominant inheritance (HP:0000006): A mode of inheritance that is observed for traits related to a gene encoded on one of the autosomes (i.e., the human chromosomes 1-22) in which a trait manifests in heterozygotes. In the context of medical genetics, an autosomal dominant disorder is caused when a single copy of the mutant allele is present. Males and females are affected equally, and can both transmit the disorder with a risk of 50% for each child of inheriting the mutant allele. Evidence: IEA. (OMIM:126500)